Phenotypes associated with the disease ptosis-vocal cord paralysis syndrome (OMIM:193240):
- Vocal cord paralysis (HP:0001605): A loss of the ability to move the vocal folds. Evidence: TAS. (OMIM:193240)
- Bilateral ptosis (HP:0001488). Evidence: IEA. (OMIM:193240)
- Autosomal dominant inheritance (HP:0000006): A mode of inheritance that is observed for traits related to a gene encoded on one of the autosomes (i.e., the human chromosomes 1-22) in which a trait manifests in heterozygotes. In the context of medical genetics, an autosomal dominant disorder is caused when a single copy of the mutant allele is present. Males and females are affected equally, and can both transmit the disorder with a risk of 50% for each child of inheriting the mutant allele. Evidence: IEA. (OMIM:193240)